Phenotypes associated with the disease ataxia with myoclonic epilepsy and presenile dementia (OMIM:208700):
- Generalized myoclonic seizure (HP:0002123): A generalized myoclonic seizure is a type of generalized motor seizure characterized by bilateral, sudden, brief (<100 ms) involuntary single or multiple contraction of muscles or muscle groups of variable topography (axial, proximal limb, distal). Myoclonus is less regularly repetitive and less sustained than is clonus. Evidence: TAS. (OMIM:208700)
- Seizure (HP:0001250): A seizure is an intermittent abnormality of nervous system physiology characterized by a transient occurrence of signs and/or symptoms due to abnormal excessive or synchronous neuronal activity in the brain. Evidence: IEA. (OMIM:208700)
- Dementia (HP:0000726): A loss of global cognitive ability of sufficient amount to interfere with normal social or occupational function. Dementia represents a loss of previously present cognitive abilities, generally in adults, and can affect memory, thinking, language, judgment, and behavior. Evidence: IEA. (OMIM:208700)
- Polyneuropathy (HP:0001271): A generalized disorder of peripheral nerves. Evidence: IEA. (OMIM:208700)
- Ataxia (HP:0001251): Ataxia refers to impaired coordination of voluntary muscle movement. Cerebellar ataxia refers to ataxia due to dysfunction of the cerebellum. This causes a variety of elementary neurological deficits including asynergy (lack of coordination between muscles, limbs and joints), dysmetria (lack of ability to judge distances that can lead to under- or overshoot in grasping movements), and dysdiadochokinesia (inability to perform rapid movements requiring antagonizing muscle groups to be switched on and off repeatedly). Evidence: IEA. (OMIM:208700)
- Autosomal recessive inheritance (HP:0000007): A mode of inheritance that is observed for traits related to a gene encoded on one of the autosomes (i.e., the human chromosomes 1-22) in which a trait manifests in individuals with two pathogenic alleles, either homozygotes (two copies of the same mutant allele) or compound heterozygotes (whereby each copy of a gene has a distinct mutant allele). Evidence: IEA. (OMIM:208700)
- Myoclonus (HP:0001336): Very brief, involuntary random muscular contractions occurring at rest, in response to sensory stimuli, or accompanying voluntary movements. Evidence: IEA. (OMIM:208700)